- Abnormality of the skeletal system (HP:0000924): An abnormality of the skeletal system. Evidence: IEA. (OMIM:600356)
- Autosomal dominant inheritance (HP:0000006): A mode of inheritance that is observed for traits related to a gene encoded on one of the autosomes (i.e., the human chromosomes 1-22) in which a trait manifests in heterozygotes. In the context of medical genetics, an autosomal dominant disorder is caused when a single copy of the mutant allele is present. Males and females are affected equally, and can both transmit the disorder with a risk of 50% for each child of inheriting the mutant allele. Evidence: TAS. (OMIM:600356)
These phenotypes are associated with the disease pachydermodactyly, familial (OMIM:600356).